Phenotypes associated with the disease Floating-Harbor syndrome (ORPHA:2044):
- Small for gestational age (HP:0001518): Smaller than normal size according to sex and gestational age related norms, defined as a weight below the 10th percentile for the gestational age. Evidence: TAS. Frequency: Very frequent (HP:0040281). (ORPHA:2044)
- Short stature (HP:0004322): A height below that which is expected according to age and gender norms. Although there is no universally accepted definition of short stature, many refer to "short stature" as height more than 2 standard deviations below the mean for age and gender (or below the 3rd percentile for age and gender dependent norms). Evidence: TAS. Frequency: Very frequent (HP:0040281). (ORPHA:2044)
- Speech apraxia (HP:0011098): A type of apraxia that is characterized by difficulty or inability to execute speech movements because of problems with coordination and motor problems, leading to incorrect articulation. An increase of errors with increasing word and phrase length may occur. Evidence: TAS. Frequency: Very frequent (HP:0040281). (ORPHA:2044)
- Wide mouth (HP:0000154): Distance between the oral commissures more than 2 SD above the mean. Alternatively, an apparently increased width of the oral aperture (subjective). Evidence: TAS. Frequency: Frequent (HP:0040282). (ORPHA:2044)
- Triangular face (HP:0000325): Facial contour, as viewed from the front, triangular in shape, with breadth at the temples and tapering to a narrow chin. Evidence: TAS. Frequency: Frequent (HP:0040282). (ORPHA:2044)
- Short neck (HP:0000470): Diminished length of the neck. Evidence: TAS. Frequency: Frequent (HP:0040282). (ORPHA:2044)
- Strabismus (HP:0000486): A misalignment of the eyes so that the visual axes deviate from bifoveal fixation. The classification of strabismus may be based on a number of features including the relative position of the eyes, whether the deviation is latent or manifest, intermittent or constant, concomitant or otherwise and according to the age of onset and the relevance of any associated refractive error. Evidence: TAS. Frequency: Frequent (HP:0040282). (ORPHA:2044)
- Delayed speech and language development (HP:0000750): A degree of language development that is significantly below the norm for a child of a specified age. Evidence: TAS. Frequency: Frequent (HP:0040282). (ORPHA:2044)
- Shield chest (HP:0000914): A broad chest. Evidence: TAS. Frequency: Frequent (HP:0040282). (ORPHA:2044)
- Mild intellectual disability (HP:0001256): Mild intellectual disability (ID) is defined as a type of ID characterized by mildly sub-average adaptive functioning and intellectual functioning, with an intelligence quotient (IQ) the range of 50-69. Evidence: TAS. Frequency: Frequent (HP:0040282). (ORPHA:2044)
- Growth delay (HP:0001510): A deficiency or slowing down of growth pre- and postnatally. Evidence: TAS. Frequency: Frequent (HP:0040282). (ORPHA:2044)
- Moderate intellectual disability (HP:0002342): Moderate intellectual disability (ID) is defined as a type of ID characterized by moderately sub-average adaptive functioning and intellectual functioning, with an intelligence quotient (IQ) the range of 35-49. Evidence: TAS. Frequency: Frequent (HP:0040282). (ORPHA:2044)
- Delayed skeletal maturation (HP:0002750): A decreased rate of skeletal maturation. Delayed skeletal maturation can be diagnosed on the basis of an estimation of the bone age from radiographs of specific bones in the human body. Evidence: TAS. Frequency: Frequent (HP:0040282). (ORPHA:2044)
- Cryptorchidism (HP:0000028): Testis in inguinal canal. That is, absence of one or both testes from the scrotum owing to failure of the testis or testes to descend through the inguinal canal to the scrotum. Evidence: TAS. Frequency: Occasional (HP:0040283). (ORPHA:2044)
- Hypospadias (HP:0000047): Abnormal position of urethral meatus on the ventral penile shaft (underside) characterized by displacement of the urethral meatus from the tip of the glans penis to the ventral surface of the penis, scrotum, or perineum. Evidence: TAS. Frequency: Occasional (HP:0040283). (ORPHA:2044)
- Renal agenesis (HP:0000104): Agenesis, that is, failure of the kidney to develop during embryogenesis and development. Evidence: TAS. Frequency: Occasional (HP:0040283). (ORPHA:2044)
- Renal cyst (HP:0000107): A fluid filled sac in the kidney. Evidence: TAS. Frequency: Occasional (HP:0040283). (ORPHA:2044)
- Nephrocalcinosis (HP:0000121): Nephrocalcinosis is the deposition of calcium salts in renal parenchyma. Evidence: TAS. Frequency: Occasional (HP:0040283). (ORPHA:2044)
- Hydronephrosis (HP:0000126): Severe distention of the kidney with dilation of the renal pelvis and calices. Evidence: TAS. Frequency: Occasional (HP:0040283). (ORPHA:2044)
- Short philtrum (HP:0000322): Distance between nasal base and midline upper lip vermilion border more than 2 SD below the mean. Alternatively, an apparently decreased distance between nasal base and midline upper lip vermilion border. Evidence: TAS. Frequency: Occasional (HP:0040283). (ORPHA:2044)
- Hypoplasia of the maxilla (HP:0000327): Abnormally small dimension of the Maxilla. Usually creating a malocclusion or malalignment between the upper and lower teeth or resulting in a deficient amount of projection of the base of the nose and lower midface region. Evidence: TAS. Frequency: Occasional (HP:0040283). (ORPHA:2044)
- Low-set ears (HP:0000369): Upper insertion of the ear to the scalp below an imaginary horizontal line drawn between the inner canthi of the eye and extending posteriorly to the ear. Evidence: TAS. Frequency: Occasional (HP:0040283). (ORPHA:2044)
- Conductive hearing impairment (HP:0000405): An abnormality of vibrational conductance of sound to the inner ear leading to impairment of sensory perception of sound. Evidence: TAS. Frequency: Occasional (HP:0040283). (ORPHA:2044)
- Narrow nasal bridge (HP:0000446): Decreased width of the bony bridge of the nose. Evidence: TAS. Frequency: Occasional (HP:0040283). (ORPHA:2044)
- Broad nasal tip (HP:0000455): Increase in width of the nasal tip. Evidence: TAS. Frequency: Occasional (HP:0040283). (ORPHA:2044)
- Deeply set eye (HP:0000490): An eye that is more deeply recessed into the plane of the face than is typical. Evidence: TAS. Frequency: Occasional (HP:0040283). (ORPHA:2044)
- Hypermetropia (HP:0000540): An abnormality of refraction characterized by the ability to see objects in the distance clearly, while objects nearby appear blurry. Evidence: TAS. Frequency: Occasional (HP:0040283). (ORPHA:2044)
- Carious teeth (HP:0000670): Caries is a multifactorial bacterial infection affecting the structure of the tooth. This term has been used to describe the presence of more than expected dental caries. Evidence: TAS. Frequency: Occasional (HP:0040283). (ORPHA:2044)
- Oligodontia (HP:0000677): The absence of six or more teeth from the normal series by a failure to develop. Evidence: TAS. Frequency: Occasional (HP:0040283). (ORPHA:2044)
- Microdontia (HP:0000691): Decreased size of the teeth, which can be defined as a mesiodistal tooth diameter (width) more than 2 SD below mean. Alternatively, an apparently decreased maximum width of tooth. Evidence: TAS. Frequency: Occasional (HP:0040283). (ORPHA:2044)
- Restlessness (HP:0000711): A state of unease is characterized by diffuse motor activity or motion, which is subject to limited control, nonproductive, or disorganized behavior. Evidence: TAS. Frequency: Occasional (HP:0040283). (ORPHA:2044)
- Aggressive behavior (HP:0000718): Behavior or an act aimed at harming a person, animal, or physical property (e.g., acts of physical violence; shouting, swearing, and using harsh language; slashing someone's tires). Evidence: TAS. Frequency: Occasional (HP:0040283). (ORPHA:2044)
- Compulsive behaviors (HP:0000722): Behavior that consists of repetitive acts, characterized by the feeling that one "has to" perform them, while being aware that these acts are not in line with one's overall goal. Evidence: TAS. Frequency: Occasional (HP:0040283). (ORPHA:2044)
- Short attention span (HP:0000736): Reduced attention span characterized by distractibility and impulsivity. Evidence: TAS. Frequency: Occasional (HP:0040283). (ORPHA:2044)
- Anxiety (HP:0000739): Intense feelings of nervousness, tension, or panic often arise in response to interpersonal stresses. There is worry about the negative effects of past unpleasant experiences and future negative possibilities. Individuals may feel fearful, apprehensive, or threatened by uncertainty, and they may also have fears of falling apart or losing control. Evidence: TAS. Frequency: Occasional (HP:0040283). (ORPHA:2044)
- Precocious puberty (HP:0000826): The onset of secondary sexual characteristics before a normal age. Although it is difficult to define normal age ranges because of the marked variation with which puberty begins in normal children, precocious puberty can be defined as the onset of puberty before the age of 8 years in girls or 9 years in boys. Evidence: TAS. Frequency: Occasional (HP:0040283). (ORPHA:2044)
- 11 pairs of ribs (HP:0000878): Presence of only 11 pairs of ribs. Evidence: TAS. Frequency: Occasional (HP:0040283). (ORPHA:2044)
- Short clavicles (HP:0000894): Reduced length of the clavicles. Evidence: TAS. Frequency: Occasional (HP:0040283). (ORPHA:2044)
- Brachydactyly (HP:0001156): Digits that appear disproportionately short compared to the hand/foot. The word brachydactyly is used here to describe a series distinct patterns of shortened digits (brachydactyly types A-E). This is the sense used here. Evidence: TAS. Frequency: Occasional (HP:0040283). (ORPHA:2044)
- Seizure (HP:0001250): A seizure is an intermittent abnormality of nervous system physiology characterized by a transient occurrence of signs and/or symptoms due to abnormal excessive or synchronous neuronal activity in the brain. Evidence: TAS. Frequency: Occasional (HP:0040283). (ORPHA:2044)
- Dysarthria (HP:0001260): Dysarthric speech is a general description referring to a neurological speech disorder characterized by poor articulation. Depending on the involved neurological structures, dysarthria may be further classified as spastic, flaccid, ataxic, hyperkinetic and hypokinetic, or mixed. Evidence: TAS. Frequency: Occasional (HP:0040283). (ORPHA:2044)
- Absent speech (HP:0001344): Complete lack of development of speech and language abilities. Evidence: TAS. Frequency: Occasional (HP:0040283). (ORPHA:2044)
- Hip dysplasia (HP:0001385): The presence of developmental dysplasia of the hip. Evidence: TAS. Frequency: Occasional (HP:0040283). (ORPHA:2044)
- Hypernasal speech (HP:0001611): A type of speech characterized by the presence of an abnormally increased nasal airflow during speech associated with structural abnormality of the nasal passages. Evidence: TAS. Frequency: Occasional (HP:0040283). (ORPHA:2044)
- Abnormally high-pitched voice (HP:0001620): A persistent (minutes to hours) abnormal increase in the pitch (frequency) of the voice for the context or social situation or significantly different from baseline of the individual. Evidence: TAS. Frequency: Occasional (HP:0040283). (ORPHA:2044)
- Constipation (HP:0002019): Infrequent or difficult evacuation of feces. Evidence: TAS. Frequency: Occasional (HP:0040283). (ORPHA:2044)
- Gastroesophageal reflux (HP:0002020): A condition in which the stomach contents leak backwards from the stomach into the esophagus through the lower esophageal sphincter. Evidence: TAS. Frequency: Occasional (HP:0040283). (ORPHA:2044)
- Broad-based gait (HP:0002136): An abnormal gait pattern in which persons stand and walk with their feet spaced widely apart. This is often a component of cerebellar ataxia. Evidence: TAS. Frequency: Occasional (HP:0040283). (ORPHA:2044)
- Kyphoscoliosis (HP:0002751): An abnormal curvature of the spine in both a coronal (lateral) and sagittal (back-to-front) plane. Evidence: TAS. Frequency: Occasional (HP:0040283). (ORPHA:2044)
- Enlarged joints (HP:0003037): Increase in size of one or more joints. Evidence: TAS. Frequency: Occasional (HP:0040283). (ORPHA:2044)
- Dislocated radial head (HP:0003083): A dislocation of the head of the radius from its socket in the elbow joint. Evidence: TAS. Frequency: Occasional (HP:0040283). (ORPHA:2044)
- Long nose (HP:0003189): Distance from nasion to subnasale more than two standard deviations above the mean, or alternatively, an apparently increased length from the nasal root to the nasal base. Evidence: TAS. Frequency: Occasional (HP:0040283). (ORPHA:2044)
- Humeral pseudarthrosis (HP:0003879). Evidence: TAS. Frequency: Occasional (HP:0040283). (ORPHA:2044)
- Avascular necrosis of the capital femoral epiphysis (HP:0005743): Avascular necrosis of the proximal epiphysis of the femur occurring in growing children and caused by an interruption of the blood supply to the head of the femur close to the hip joint. The necrosis is characteristically associated with flattening of the femoral head, for which reason the term coxa plana has been used to refer to this feature in the medical literature. Evidence: TAS. Frequency: Occasional (HP:0040283). (ORPHA:2044)
- Persistence of primary teeth (HP:0006335): Persistence of the primary teeth beyond the age by which they normally are shed and replaced by the permanent teeth. Evidence: TAS. Frequency: Occasional (HP:0040283). (ORPHA:2044)
- Attention deficit hyperactivity disorder (HP:0007018): Attention deficit hyperactivity disorder (ADHD) manifests at age 2-3 years or by first grade at the latest. The main symptoms are distractibility, impulsivity, hyperactivity, and often trouble organizing tasks and projects, difficulty going to sleep, and social problems from being aggressive, loud, or impatient. Evidence: TAS. Frequency: Occasional (HP:0040283). (ORPHA:2044)
- Low hanging columella (HP:0009765): Columella extending inferior to the level of the nasal base, when viewed from the side. Evidence: TAS. Frequency: Occasional (HP:0040283). (ORPHA:2044)
- Short thumb (HP:0009778): Hypoplasia (congenital reduction in size) of the thumb. Evidence: TAS. Frequency: Occasional (HP:0040283). (ORPHA:2044)
- Short metacarpal (HP:0010049): Diminished length of one or more metacarpal bones in relation to the others of the same hand or to the contralateral metacarpal. Evidence: TAS. Frequency: Occasional (HP:0040283). (ORPHA:2044)
- Dilatation of the renal pelvis (HP:0010946): The presence of dilatation of the renal pelvis. Evidence: TAS. Frequency: Occasional (HP:0040283). (ORPHA:2044)
- Congenital posterior urethral valve (HP:0010957): A developmental defect resulting in an obstructing membrane in the posterior male urethra. Evidence: TAS. Frequency: Occasional (HP:0040283). (ORPHA:2044)
- Broad fingertip (HP:0011300): Increased width of the distal segment of a finger. Evidence: TAS. Frequency: Occasional (HP:0040283). (ORPHA:2044)
- Varicocele (HP:0012871): A varicocele is a widening of the veins along the spermatic cord, leading to enlarged, twisted veins in the scrotum, and manifested clinically by a painless testicle lump, scrotal swelling, or bulge in the scrotum. Evidence: TAS. Frequency: Occasional (HP:0040283). (ORPHA:2044)
- Abnormal temper tantrums (HP:0025160): Temper tantrums are brief episodes of extreme, unpleasant, and sometimes aggressive behaviors in response to frustration or anger, which are a normal part of development in toddlers. Temper tantrums that occur more frequently in a given time and/or are more severe in symptomatology and/or longer in duration and/or inappropriate for the given age compared to a temper tantrum that naturally occurs as a part of the developmental process are classified as abnormal temper tantrums. Evidence: TAS. Frequency: Occasional (HP:0040283). (ORPHA:2044)
- Clinodactyly (HP:0030084): An angulation of a digit at an interphalangeal joint in the plane of the palm (finger) or sole (toe). Evidence: TAS. Frequency: Occasional (HP:0040283). (ORPHA:2044)
- Epididymal cyst (HP:0030424): A smooth, extratesticular, spherical cyst in the head of the epididymis. Evidence: TAS. Frequency: Occasional (HP:0040283). (ORPHA:2044)
- Nasogastric tube feeding (HP:0040288): The condition of inability to eat normally treated by placement of a thin tube through the nose into the stomach that is then used to carry food. Evidence: TAS. Frequency: Occasional (HP:0040283). (ORPHA:2044)
- Impulsivity (HP:0100710): Acting on the spur of the moment or on a momentary basis without consideration of outcomes; having difficulty establishing or following plans; experiencing a sense of urgency and engaging in behavior that is uninhibited, cannot be inhibited, and is uncontrolled. The possibility of repression is inconceivable. Evidence: TAS. Frequency: Occasional (HP:0040283). (ORPHA:2044)
- Polycystic kidney dysplasia (HP:0000113): The presence of multiple cysts in both kidneys. Evidence: TAS. Frequency: Very rare (HP:0040284). (ORPHA:2044)
- Abnormal anterior chamber morphology (HP:0000593): Abnormality of the anterior chamber, which is the space in the eye that is behind the cornea and in front of the iris. Evidence: TAS. Frequency: Very rare (HP:0040284). (ORPHA:2044)
- Atrial septal defect (HP:0001631): Atrial septal defect (ASD) is a congenital abnormality of the interatrial septum that enables blood flow between the left and right atria via the interatrial septum. Evidence: TAS. Frequency: Very rare (HP:0040284). (ORPHA:2044)
- Tetralogy of Fallot (HP:0001636): A congenital cardiac malformation comprising pulmonary stenosis, overriding aorta, ventricular septum defect, and right ventricular hypertrophy. The diagnosis of TOF is made if at least three of the four above mentioned features are present. Evidence: TAS. Frequency: Very rare (HP:0040284). (ORPHA:2044)
- Coarctation of aorta (HP:0001680): Coarctation of the aorta is a narrowing or constriction of a segment of the aorta. Evidence: TAS. Frequency: Very rare (HP:0040284). (ORPHA:2044)
- Celiac disease (HP:0002608): Celiac disease (CD) is an autoimmune condition affecting the small intestine, triggered by the ingestion of gluten, the protein fraction of wheat, barley, and rye. Clinical manifestations of CD are highly variable and include both gastrointestinal and non-gastrointestinal features. The hallmark of CD is an immune-mediated enteropathy. This term is included because the occurrence of CD is seen as a feature of a number of other diseases. Evidence: TAS. Frequency: Very rare (HP:0040284). (ORPHA:2044)
- Stage 5 chronic kidney disease (HP:0003774): A degree of kidney failure severe enough to require dialysis or kidney transplantation for survival characterized by a severe reduction in glomerular filtration rate (less than 15 ml/min/1.73 m2) and other manifestations including increased serum creatinine. Evidence: TAS. Frequency: Very rare (HP:0040284). (ORPHA:2044)
- Persistent left superior vena cava (HP:0005301): A rare congenital vascular anomaly that results when the left superior cardinal vein caudal to the innominate vein fails to regress. Evidence: TAS. Frequency: Very rare (HP:0040284). (ORPHA:2044)
- Cochlear malformation (HP:0008554): The presence of a malformed cochlea. Evidence: TAS. Frequency: Very rare (HP:0040284). (ORPHA:2044)
- Mesocardia (HP:0011599): Mesocardia is an abnormal location of the heart in which the heart is in a midline position and the longitudinal axis of the heart lies in the mid-sagittal plane. Evidence: TAS. Frequency: Very rare (HP:0040284). (ORPHA:2044)
- Gluten intolerance (HP:0012538): A detrimental reaction to the presence of gluten in food, which may include abdominal pain, fatigue, headaches and paresthesia, or celiac disease. Evidence: TAS. Frequency: Very rare (HP:0040284). (ORPHA:2044)